- Joint hypermobility (HP:0001382): The capability that a joint (or a group of joints) has to move, passively and/or actively, beyond normal limits along physiological axes. Evidence: TAS. Frequency: Frequent (HP:0040282). (ORPHA:96264)
- Azoospermia (HP:0000027): Absence of any measurable level of sperm,whereby spermatozoa cannot be observed even after centrifugation of the semen pellet. Evidence: TAS. Frequency: Very frequent (HP:0040281). (ORPHA:96264)
- Hypogonadism (HP:0000135): A decreased functionality of the gonad. Evidence: TAS. Frequency: Very frequent (HP:0040281). (ORPHA:96264)
- Carious teeth (HP:0000670): Caries is a multifactorial bacterial infection affecting the structure of the tooth. This term has been used to describe the presence of more than expected dental caries. Evidence: TAS. Frequency: Very frequent (HP:0040281). (ORPHA:96264)
- Abnormal dental enamel morphology (HP:0000682): An abnormality of the dental enamel. Evidence: TAS. Frequency: Very frequent (HP:0040281). (ORPHA:96264)
- Infertility (HP:0000789). Evidence: TAS. Frequency: Very frequent (HP:0040281). (ORPHA:96264)
- Intellectual disability (HP:0001249): The term intellectual disability or intellectual developmental disorder is used to describe significantly sub-average intellectual and adaptive functioning based on clinical assessment and as measured by individually administered, appropriately normed, standardized and validated tests of intellectual functioning and adaptive behavior, with onset during the developmental period from infancy through adolescence. Evidence: TAS. Frequency: Very frequent (HP:0040281). (ORPHA:96264)
- Hypotonia (HP:0001252): Hypotonia is an abnormally low muscle tone (the amount of tension or resistance to movement in a muscle). Even when relaxed, muscles have a continuous and passive partial contraction which provides some resistance to passive stretching. Hypotonia thus manifests as diminished resistance to passive stretching. Hypotonia is not the same as muscle weakness, although the two conditions can co-exist. Evidence: TAS. Frequency: Very frequent (HP:0040281). (ORPHA:96264)
- Global developmental delay (HP:0001263): A delay in the achievement of motor or mental milestones in the domains of development of a child, including motor skills, speech and language, cognitive skills, and social and emotional skills. This term should only be used to describe children younger than five years of age. Evidence: TAS. Frequency: Very frequent (HP:0040281). (ORPHA:96264)
- Language impairment (HP:0002463): Language impairment is a deficit in comprehension or production of language that includes reduced vocabulary, limited sentence structure, or impairments in written or spoken communication. Language abilities are substantially and quantifiably below age expectations. Evidence: TAS. Frequency: Very frequent (HP:0040281). (ORPHA:96264)
- Decreased testicular size (HP:0008734): Reduced volume of the testicle (the male gonad). Evidence: TAS. Frequency: Very frequent (HP:0040281). (ORPHA:96264)
- Hypoplasia of penis (HP:0008736). Evidence: TAS. Frequency: Very frequent (HP:0040281). (ORPHA:96264)
- Open bite (HP:0010807): Visible space between the dental arches in occlusion. Evidence: TAS. Frequency: Very frequent (HP:0040281). (ORPHA:96264)
- Cryptorchidism (HP:0000028): Testis in inguinal canal. That is, absence of one or both testes from the scrotum owing to failure of the testis or testes to descend through the inguinal canal to the scrotum. Evidence: TAS. Frequency: Frequent (HP:0040282). (ORPHA:96264)
- Small scrotum (HP:0000046): Apparently small scrotum for age. Evidence: TAS. Frequency: Frequent (HP:0040282). (ORPHA:96264)
- Renal dysplasia (HP:0000110): The presence of developmental dysplasia of the kidney. Evidence: TAS. Frequency: Frequent (HP:0040282). (ORPHA:96264)
- Epicanthus (HP:0000286): A fold of skin starting above the medial aspect of the upper eyelid and arching downward to cover, pass in front of and lateral to the medial canthus. Evidence: TAS. Frequency: Frequent (HP:0040282). (ORPHA:96264)
- Hypertelorism (HP:0000316): Interpupillary distance more than 2 SD above the mean (alternatively, the appearance of an increased interpupillary distance or widely spaced eyes). Evidence: TAS. Frequency: Frequent (HP:0040282). (ORPHA:96264)
- Chronic otitis media (HP:0000389): Chronic otitis media refers to fluid, swelling, or infection of the middle ear that does not heal and may cause permanent damage to the ear. Evidence: TAS. Frequency: Frequent (HP:0040282). (ORPHA:96264)
- Strabismus (HP:0000486): A misalignment of the eyes so that the visual axes deviate from bifoveal fixation. The classification of strabismus may be based on a number of features including the relative position of the eyes, whether the deviation is latent or manifest, intermittent or constant, concomitant or otherwise and according to the age of onset and the relevance of any associated refractive error. Evidence: TAS. Frequency: Frequent (HP:0040282). (ORPHA:96264)
- Myopia (HP:0000545): An abnormality of refraction characterized by the ability to see objects nearby clearly, while objects in the distance appear blurry. Evidence: TAS. Frequency: Frequent (HP:0040282). (ORPHA:96264)
- Blepharophimosis (HP:0000581): A fixed reduction in the vertical distance between the upper and lower eyelids with short palpebral fissures. Evidence: TAS. Frequency: Frequent (HP:0040282). (ORPHA:96264)
- Upslanted palpebral fissure (HP:0000582): The palpebral fissure inclination is more than two standard deviations above the mean for age (objective); or, the inclination of the palpebral fissure is greater than typical for age. Evidence: TAS. Frequency: Frequent (HP:0040282). (ORPHA:96264)
- Taurodontia (HP:0000679): Increased volume of dental pulp of permanent molar characterized by a crown body-root ratio equal or larger than 1:1 or an elongated pulp chambers and apical displacement of the bifurcation or trifurcation of the roots. Evidence: TAS. Frequency: Frequent (HP:0040282). (ORPHA:96264)
- Delayed eruption of teeth (HP:0000684): Delayed tooth eruption, which can be defined as tooth eruption more than 2 SD beyond the mean eruption age. Evidence: TAS. Frequency: Frequent (HP:0040282). (ORPHA:96264)
- Autism (HP:0000717): Autism is a neurodevelopmental disorder characterized by impaired social interaction and communication, and by restricted and repetitive behavior. Autism begins in childhood. It is marked by the presence of markedly abnormal or impaired development in social interaction and communication and a markedly restricted repertoire of activity and interest. Manifestations of the disorder vary greatly depending on the developmental level and chronological age of the individual (DSM-IV). Evidence: TAS. Frequency: Frequent (HP:0040282). (ORPHA:96264)
- Gynecomastia (HP:0000771): Abnormal development of large mammary glands in males resulting in breast enlargement. Evidence: TAS. Frequency: Frequent (HP:0040282). (ORPHA:96264)
- Seizure (HP:0001250): A seizure is an intermittent abnormality of nervous system physiology characterized by a transient occurrence of signs and/or symptoms due to abnormal excessive or synchronous neuronal activity in the brain. Evidence: TAS. Frequency: Frequent (HP:0040282). (ORPHA:96264)
- Pes planus (HP:0001763): A foot where the longitudinal arch of the foot is in contact with the ground or floor when the individual is standing; or, in a patient lying supine, a foot where the arch is in contact with the surface of a flat board pressed against the sole of the foot by the examiner with a pressure similar to that expected from weight bearing; or, the height of the arch is reduced. Evidence: TAS. Frequency: Frequent (HP:0040282). (ORPHA:96264)
- Constipation (HP:0002019): Infrequent or difficult evacuation of feces. Evidence: TAS. Frequency: Frequent (HP:0040282). (ORPHA:96264)
- Asthma (HP:0002099): Asthma is characterized by increased responsiveness of the tracheobronchial tree to multiple stimuli, leading to narrowing of the air passages with resultant dyspnea, cough, and wheezing. Evidence: TAS. Frequency: Frequent (HP:0040282). (ORPHA:96264)
- Recurrent respiratory infections (HP:0002205): An increased susceptibility to respiratory infections as manifested by a history of recurrent respiratory infections. Evidence: TAS. Frequency: Frequent (HP:0040282). (ORPHA:96264)
- Scoliosis (HP:0002650): The presence of an abnormal lateral curvature of the spine. Evidence: TAS. Frequency: Frequent (HP:0040282). (ORPHA:96264)
- Coxa valga (HP:0002673): Coxa valga is a deformity of the hip in which the angle between the femoral shaft and the femoral neck is increased compared to age-adjusted values (about 150 degrees in newborns gradually reducing to 120-130 degrees in adults). Evidence: TAS. Frequency: Frequent (HP:0040282). (ORPHA:96264)
- Hip dislocation (HP:0002827): Displacement of the femur from its normal location in the hip joint. Evidence: TAS. Frequency: Frequent (HP:0040282). (ORPHA:96264)
- Radioulnar synostosis (HP:0002974): An abnormal osseous union (fusion) between the radius and the ulna. Evidence: TAS. Frequency: Frequent (HP:0040282). (ORPHA:96264)
- Elbow dislocation (HP:0003042): Dislocation of the distal humerus out of the elbow joint, where the radius, ulna, and humerus meet. Evidence: TAS. Frequency: Frequent (HP:0040282). (ORPHA:96264)
- Clinodactyly of the 5th finger (HP:0004209): Clinodactyly refers to a bending or curvature of the fifth finger in the radial direction (i.e., towards the 4th finger). Evidence: TAS. Frequency: Frequent (HP:0040282). (ORPHA:96264)
- Abnormal epiphysis morphology (HP:0005930): An anomaly of epiphysis, which is the expanded articular end of a long bone that developes from a secondary ossification center, and which during the period of growth is either entirely cartilaginous or is separated from the shaft by a cartilaginous disk. Evidence: TAS. Frequency: Frequent (HP:0040282). (ORPHA:96264)
- Attention deficit hyperactivity disorder (HP:0007018): Attention deficit hyperactivity disorder (ADHD) manifests at age 2-3 years or by first grade at the latest. The main symptoms are distractibility, impulsivity, hyperactivity, and often trouble organizing tasks and projects, difficulty going to sleep, and social problems from being aggressive, loud, or impatient. Evidence: TAS. Frequency: Frequent (HP:0040282). (ORPHA:96264)
- Down-sloping shoulders (HP:0200021): Low set, steeply sloping shoulders. Evidence: TAS. Frequency: Frequent (HP:0040282). (ORPHA:96264)
- Cleft palate (HP:0000175): Cleft palate is a developmental defect of the palate resulting from a failure of fusion of the palatine processes and manifesting as a separation of the roof of the mouth (soft and hard palate). Evidence: TAS. Frequency: Occasional (HP:0040283). (ORPHA:96264)
- Brachycephaly (HP:0000248): An abnormality of skull shape characterized by a decreased anterior-posterior diameter. That is, a cephalic index greater than 81%. Alternatively, an apparently shortened anteroposterior dimension (length) of the head compared to width. Evidence: TAS. Frequency: Occasional (HP:0040283). (ORPHA:96264)
- Mandibular prognathia (HP:0000303): Abnormal prominence of the chin related to increased length of the mandible. Evidence: TAS. Frequency: Occasional (HP:0040283). (ORPHA:96264)
- Wide nose (HP:0000445): Interalar distance more than two standard deviations above the mean for age, i.e., an apparently increased width of the nasal base and alae. Evidence: TAS. Frequency: Occasional (HP:0040283). (ORPHA:96264)
- Depressed nasal ridge (HP:0000457): Lack of prominence of the nose resulting from a posteriorly-placed nasal ridge. Evidence: TAS. Frequency: Occasional (HP:0040283). (ORPHA:96264)
- Short neck (HP:0000470): Diminished length of the neck. Evidence: TAS. Frequency: Occasional (HP:0040283). (ORPHA:96264)
- Irritability (HP:0000737): An emotional state characterized by negative feelings of heightened frustration, annoyance, or feeling upset, often triggered by internal factors (e.g., fatigue, hunger, unfulfilled desires) or external factors (e.g., social or environmental challenges). Irritability may be unpredictable, and is accompanied by a lowered threshold for emotional reactivity and observable features (speech, facial expressions, or psychomotor activity). Evidence: TAS. Frequency: Occasional (HP:0040283). (ORPHA:96264)
- Low frustration tolerance (HP:0000744): The feeling of frustration can be defined as an emotional reaction that occurs when a desired goal is not achieved. Frustration intolerance is defined as an age-inappropriate response to frustration, characterized by crying or temper tantrums in children, or aggressive or other maladaptive behaviors. Evidence: TAS. Frequency: Occasional (HP:0040283). (ORPHA:96264)
- Tremor (HP:0001337): An unintentional, oscillating to-and-fro muscle movement about a joint axis. Evidence: TAS. Frequency: Occasional (HP:0040283). (ORPHA:96264)
- Holoprosencephaly (HP:0001360): Holoprosencephaly is a structural anomaly of the brain in which the developing forebrain fails to divide into two separate hemispheres and ventricles. Evidence: TAS. Frequency: Occasional (HP:0040283). (ORPHA:96264)
- Talipes equinovarus (HP:0001762): Talipes equinovarus (also called clubfoot) typically has four main components: inversion and adduction of the forefoot; inversion of the heel and hindfoot; equinus (limitation of extension) of the ankle and subtalar joint; and internal rotation of the leg. Evidence: TAS. Frequency: Occasional (HP:0040283). (ORPHA:96264)
- Gastroesophageal reflux (HP:0002020): A condition in which the stomach contents leak backwards from the stomach into the esophagus through the lower esophageal sphincter. Evidence: TAS. Frequency: Occasional (HP:0040283). (ORPHA:96264)
- Hypoplasia of the corpus callosum (HP:0002079): Underdevelopment of the corpus callosum. Evidence: TAS. Frequency: Occasional (HP:0040283). (ORPHA:96264)
- Arrhinencephaly (HP:0002139): A defect of development of the brain characterized by congenital absence of the part of the brain that includes the olfactory bulbs, tracts, and other structures associated with the sense of smell. Evidence: TAS. Frequency: Occasional (HP:0040283). (ORPHA:96264)
- Pulmonary embolism (HP:0002204): An embolus (that is, an abnormal particle circulating in the blood) located in the pulmonary artery and thereby blocking blood circulation to the lung. Usually the embolus is a blood clot that has developed in an extremity (for instance, a deep venous thrombosis), detached, and traveled through the circulation before becoming trapped in the pulmonary artery. Evidence: TAS. Frequency: Occasional (HP:0040283). (ORPHA:96264)
- Short stature (HP:0004322): A height below that which is expected according to age and gender norms. Although there is no universally accepted definition of short stature, many refer to "short stature" as height more than 2 standard deviations below the mean for age and gender (or below the 3rd percentile for age and gender dependent norms). Evidence: TAS. Frequency: Occasional (HP:0040283). (ORPHA:96264)
- Venous thrombosis (HP:0004936): Formation of a blood clot (thrombus) inside a vein, causing the obstruction of blood flow. Evidence: TAS. Frequency: Occasional (HP:0040283). (ORPHA:96264)
- Depressed nasal bridge (HP:0005280): Posterior positioning of the nasal root in relation to the overall facial profile for age. Evidence: TAS. Frequency: Occasional (HP:0040283). (ORPHA:96264)
- Type II diabetes mellitus (HP:0005978): A type of diabetes mellitus initially characterized by insulin resistance and hyperinsulinemia and subsequently by glucose interolerance and hyperglycemia. Evidence: TAS. Frequency: Occasional (HP:0040283). (ORPHA:96264)
- Renal hypoplasia/aplasia (HP:0008678): Absence or underdevelopment of the kidney. Evidence: TAS. Frequency: Occasional (HP:0040283). (ORPHA:96264)
- Abnormal cardiovascular system morphology (HP:0030680): Any structural anomaly of the heart and blood vessels. Evidence: TAS. Frequency: Occasional (HP:0040283). (ORPHA:96264)
- Overfriendliness (HP:0100025): A form of hypersociability that presents as mostly inappropriate friendliness towards others. Evidence: TAS. Frequency: Occasional (HP:0040283). (ORPHA:96264)
- Excessive shyness (HP:0100962): Atypically high degree of awkwardness or apprehension experienced when approaching or being approached by others. Evidence: TAS. Frequency: Occasional (HP:0040283). (ORPHA:96264)
These phenotypes are associated with the disease 49,XXXXY syndrome (ORPHA:96264).